- Autistic behavior (HP:0000729): Persistent deficits in social interaction and communication and interaction as well as a markedly restricted repertoire of activity and interest as well as repetitive patterns of behavior. Evidence: TAS. Frequency: Very frequent (HP:0040281). (ORPHA:647799)
- Delayed speech and language development (HP:0000750): A degree of language development that is significantly below the norm for a child of a specified age. Evidence: TAS. Frequency: Very frequent (HP:0040281). (ORPHA:647799)
- Intellectual disability (HP:0001249): The term intellectual disability or intellectual developmental disorder is used to describe significantly sub-average intellectual and adaptive functioning based on clinical assessment and as measured by individually administered, appropriately normed, standardized and validated tests of intellectual functioning and adaptive behavior, with onset during the developmental period from infancy through adolescence. Evidence: TAS. Frequency: Very frequent (HP:0040281). (ORPHA:647799)
- Global developmental delay (HP:0001263): A delay in the achievement of motor or mental milestones in the domains of development of a child, including motor skills, speech and language, cognitive skills, and social and emotional skills. This term should only be used to describe children younger than five years of age. Evidence: TAS. Frequency: Very frequent (HP:0040281). (ORPHA:647799)
- Delayed fine motor development (HP:0010862): A type of motor delay characterized by a delay in acquiring the ability to control the fingers and hands. Evidence: TAS. Frequency: Very frequent (HP:0040281). (ORPHA:647799)
- Full cheeks (HP:0000293): Increased prominence or roundness of soft tissues between zygomata and mandible. Evidence: TAS. Frequency: Frequent (HP:0040282). (ORPHA:647799)
- Bulbous nose (HP:0000414): Increased volume and globular shape of the anteroinferior aspect of the nose. Evidence: TAS. Frequency: Frequent (HP:0040282). (ORPHA:647799)
- Deeply set eye (HP:0000490): An eye that is more deeply recessed into the plane of the face than is typical. Evidence: TAS. Frequency: Frequent (HP:0040282). (ORPHA:647799)
- Aggressive behavior (HP:0000718): Behavior or an act aimed at harming a person, animal, or physical property (e.g., acts of physical violence; shouting, swearing, and using harsh language; slashing someone's tires). Evidence: TAS. Frequency: Frequent (HP:0040282). (ORPHA:647799)
- Motor stereotypy (HP:0000733): Use of the same abnormal action in response to certain triggers or at random. They may be used as a way to regulate one's internal state but must otherwise have no apparent functional purpose. Evidence: TAS. Frequency: Frequent (HP:0040282). (ORPHA:647799)
- Motor delay (HP:0001270): A type of Developmental delay characterized by a delay in acquiring motor skills. Evidence: TAS. Frequency: Frequent (HP:0040282). (ORPHA:647799)
- Specific learning disability (HP:0001328): Impairment of certain skills such as reading or writing, coordination, self-control, or attention that interfere with the ability to learn. The impairment is not related to a global deficiency of intelligence. Evidence: TAS. Frequency: Frequent (HP:0040282). (ORPHA:647799)
- Obesity (HP:0001513): Accumulation of substantial excess body fat. Evidence: TAS. Frequency: Frequent (HP:0040282). (ORPHA:647799)
- Exaggerated cupid's bow (HP:0002263): More pronounced paramedian peaks and median notch of the Cupid's bow. Evidence: TAS. Frequency: Frequent (HP:0040282). (ORPHA:647799)
- Moderate intellectual disability (HP:0002342): Moderate intellectual disability (ID) is defined as a type of ID characterized by moderately sub-average adaptive functioning and intellectual functioning, with an intelligence quotient (IQ) the range of 35-49. Evidence: TAS. Frequency: Frequent (HP:0040282). (ORPHA:647799)
- Sleep disturbance (HP:0002360): An abnormal pattern in the quality, quantity, or characteristics of sleep. Evidence: TAS. Frequency: Frequent (HP:0040282). (ORPHA:647799)
- Polyphagia (HP:0002591): A neurological anomaly with gross overeating associated with an abnormally strong desire or need to eat. Evidence: TAS. Frequency: Frequent (HP:0040282). (ORPHA:647799)
- Attention deficit hyperactivity disorder (HP:0007018): Attention deficit hyperactivity disorder (ADHD) manifests at age 2-3 years or by first grade at the latest. The main symptoms are distractibility, impulsivity, hyperactivity, and often trouble organizing tasks and projects, difficulty going to sleep, and social problems from being aggressive, loud, or impatient. Evidence: TAS. Frequency: Frequent (HP:0040282). (ORPHA:647799)
- Almond-shaped palpebral fissure (HP:0007874): A shape created by an acute downward arching of the upper eyelid and upward arching of the lower eyelid, toward the medial canthus, which gives the outline of the palpebral fissures the configuration of an almond. Thus, the maximum distance between the fissures is offset from, and medial to, the center point. Evidence: TAS. Frequency: Frequent (HP:0040282). (ORPHA:647799)
- Floppy infant (HP:0008947): Floppiness/hypotonia is defined as reduced resistance to passive movement of joints. Physical examination of floppy/hypotonic infants shows head lag, lack of shoulder and elbow muscle contraction on traction response, inability to tighten the shoulder girdle muscles (or slipping through) when held under the axillae, scarf sign (when the arm is pulled to the opposite side, the arm wraps around the neck with the elbow crossing midline), hyperdorsiflexion of the feet, easy apposition of the thumb against the forearm, feet touching the cheek with ease and without discomfort, frog leg position, and inverted U sign on ventral suspension (head, arms, and legs hanging down without elbow or knee flexion and the trunk rounded in a dome shape). Evidence: TAS. Frequency: Frequent (HP:0040282). (ORPHA:647799)
- Abnormality of coordination (HP:0011443). Evidence: TAS. Frequency: Frequent (HP:0040282). (ORPHA:647799)
- Fatigue (HP:0012378): A subjective feeling of tiredness characterized by a lack of energy and motivation. Evidence: TAS. Frequency: Frequent (HP:0040282). (ORPHA:647799)
- Impulsivity (HP:0100710): Acting on the spur of the moment or on a momentary basis without consideration of outcomes; having difficulty establishing or following plans; experiencing a sense of urgency and engaging in behavior that is uninhibited, cannot be inhibited, and is uncontrolled. The possibility of repression is inconceivable. Evidence: TAS. Frequency: Frequent (HP:0040282). (ORPHA:647799)
- Abnormal eating behavior (HP:0100738): Abnormal eating habits involve excessive or insufficient consumption of food, or any other abnormal pattern of food consumption. Evidence: TAS. Frequency: Frequent (HP:0040282). (ORPHA:647799)
- Cryptorchidism (HP:0000028): Testis in inguinal canal. That is, absence of one or both testes from the scrotum owing to failure of the testis or testes to descend through the inguinal canal to the scrotum. Evidence: TAS. Frequency: Occasional (HP:0040283). (ORPHA:647799)
- Microcephaly (HP:0000252): Head circumference below 2 standard deviations below the mean for age and gender. Evidence: TAS. Frequency: Occasional (HP:0040283). (ORPHA:647799)
- Astigmatism (HP:0000483): A type of refraction error associated with abnormal curvatures on the anterior and/or posterior surface of the cornea. Evidence: TAS. Frequency: Occasional (HP:0040283). (ORPHA:647799)
- Strabismus (HP:0000486): A misalignment of the eyes so that the visual axes deviate from bifoveal fixation. The classification of strabismus may be based on a number of features including the relative position of the eyes, whether the deviation is latent or manifest, intermittent or constant, concomitant or otherwise and according to the age of onset and the relevance of any associated refractive error. Evidence: TAS. Frequency: Occasional (HP:0040283). (ORPHA:647799)
- Hypermetropia (HP:0000540): An abnormality of refraction characterized by the ability to see objects in the distance clearly, while objects nearby appear blurry. Evidence: TAS. Frequency: Occasional (HP:0040283). (ORPHA:647799)
- Anxiety (HP:0000739): Intense feelings of nervousness, tension, or panic often arise in response to interpersonal stresses. There is worry about the negative effects of past unpleasant experiences and future negative possibilities. Individuals may feel fearful, apprehensive, or threatened by uncertainty, and they may also have fears of falling apart or losing control. Evidence: TAS. Frequency: Occasional (HP:0040283). (ORPHA:647799)
- Reduced eye contact (HP:0000817): A reduced frequency or duration of eye contact. Evidence: TAS. Frequency: Occasional (HP:0040283). (ORPHA:647799)
- Seizure (HP:0001250): A seizure is an intermittent abnormality of nervous system physiology characterized by a transient occurrence of signs and/or symptoms due to abnormal excessive or synchronous neuronal activity in the brain. Evidence: TAS. Frequency: Occasional (HP:0040283). (ORPHA:647799)
- Mild intellectual disability (HP:0001256): Mild intellectual disability (ID) is defined as a type of ID characterized by mildly sub-average adaptive functioning and intellectual functioning, with an intelligence quotient (IQ) the range of 50-69. Evidence: TAS. Frequency: Occasional (HP:0040283). (ORPHA:647799)
- Neonatal hypotonia (HP:0001319): Muscular hypotonia (abnormally low muscle tone) manifesting in the neonatal period. Evidence: TAS. Frequency: Occasional (HP:0040283). (ORPHA:647799)
- Failure to thrive (HP:0001508): Failure to thrive (FTT) refers to a child whose physical growth is substantially below the norm. Evidence: TAS. Frequency: Occasional (HP:0040283). (ORPHA:647799)
- Intrauterine growth retardation (HP:0001511): An abnormal restriction of fetal growth with fetal weight below the tenth percentile for gestational age. Evidence: TAS. Frequency: Occasional (HP:0040283). (ORPHA:647799)
- Decreased fetal movement (HP:0001558): An abnormal reduction in quantity or strength of fetal movements. Evidence: TAS. Frequency: Occasional (HP:0040283). (ORPHA:647799)
- Premature birth (HP:0001622): The birth of a baby of less than 37 weeks of gestational age. Evidence: TAS. Frequency: Occasional (HP:0040283). (ORPHA:647799)
- Neonatal hypoglycemia (HP:0001998). Evidence: TAS. Frequency: Occasional (HP:0040283). (ORPHA:647799)
- Gastroesophageal reflux (HP:0002020): A condition in which the stomach contents leak backwards from the stomach into the esophagus through the lower esophageal sphincter. Evidence: TAS. Frequency: Occasional (HP:0040283). (ORPHA:647799)
- Respiratory distress (HP:0002098): Respiratory distress is objectively observable as the physical or emotional consequences from the experience of dyspnea. The physical presentation of respiratory distress is generally referred to as labored breathing, while the sensation of respiratory distress is called shortness of breath or dyspnea. Evidence: TAS. Frequency: Occasional (HP:0040283). (ORPHA:647799)
- Ventriculomegaly (HP:0002119): An increase in size of the ventricular system of the brain. Evidence: TAS. Frequency: Occasional (HP:0040283). (ORPHA:647799)
- Bruxism (HP:0003763): Bruxism is characterized by the grinding of the teeth including the clenching of the jaw and typically occur during sleep. Evidence: TAS. Frequency: Occasional (HP:0040283). (ORPHA:647799)
- Short stature (HP:0004322): A height below that which is expected according to age and gender norms. Although there is no universally accepted definition of short stature, many refer to "short stature" as height more than 2 standard deviations below the mean for age and gender (or below the 3rd percentile for age and gender dependent norms). Evidence: TAS. Frequency: Occasional (HP:0040283). (ORPHA:647799)
- Congenital muscular torticollis (HP:0005988): A congenital form of torticollis resulting from shortening of the sternocleidomastoid muscle and leading to a limited range of motion in both rotation and lateral bending. Evidence: TAS. Frequency: Occasional (HP:0040283). (ORPHA:647799)
- Maternal hypertension (HP:0008071): Increased blood pressure during a pregnancy. Evidence: TAS. Frequency: Occasional (HP:0040283). (ORPHA:647799)
- Feeding difficulties in infancy (HP:0008872): Impaired feeding performance of an infant as manifested by difficulties such as weak and ineffective sucking, brief bursts of sucking, and falling asleep during sucking. There may be difficulties with chewing or maintaining attention. Evidence: TAS. Frequency: Occasional (HP:0040283). (ORPHA:647799)
- Maternal diabetes (HP:0009800): Maternal diabetes can either be a gestational, mostly type 2 diabetes, or a type 1 diabetes. Essential is the resulting maternal hyperglycemia as a non-specific teratogen, imposing the same risk of congenital malformations to pregnant women with both type 1 and type2 diabetes. Evidence: TAS. Frequency: Occasional (HP:0040283). (ORPHA:647799)
- Severe intellectual disability (HP:0010864): Severe intellectual disability (ID) is defined as a type of ID characterized by severely sub-average adaptive functioning and intellectual functioning, with an intelligence quotient (IQ) the range of 20-34. Evidence: TAS. Frequency: Occasional (HP:0040283). (ORPHA:647799)
- Abnormal temper tantrums (HP:0025160): Temper tantrums are brief episodes of extreme, unpleasant, and sometimes aggressive behaviors in response to frustration or anger, which are a normal part of development in toddlers. Temper tantrums that occur more frequently in a given time and/or are more severe in symptomatology and/or longer in duration and/or inappropriate for the given age compared to a temper tantrum that naturally occurs as a part of the developmental process are classified as abnormal temper tantrums. Evidence: TAS. Frequency: Occasional (HP:0040283). (ORPHA:647799)
- Overweight (HP:0025502): Increased body weight with a body mass index of 25-29.9 kg per square meter. Evidence: TAS. Frequency: Occasional (HP:0040283). (ORPHA:647799)
- Polyembolokoilamania (HP:0032508): Habitual insertion of foreign bodies into bodily orifices. Evidence: TAS. Frequency: Occasional (HP:0040283). (ORPHA:647799)
- Tachyphagia (HP:6000352): Excessively rapid eating of food. Evidence: TAS. Frequency: Occasional (HP:0040283). (ORPHA:647799)
- Micropenis (HP:0000054): Abnormally small penis. At birth, the normal penis is about 3 cm (stretched length from pubic tubercle to tip of penis) with micropenis less than 2.0-2.5 cm. Evidence: TAS. Frequency: Very rare (HP:0040284). (ORPHA:647799)
- Renal cyst (HP:0000107): A fluid filled sac in the kidney. Evidence: TAS. Frequency: Very rare (HP:0040284). (ORPHA:647799)
- Hypogonadism (HP:0000135): A decreased functionality of the gonad. Evidence: TAS. Frequency: Very rare (HP:0040284). (ORPHA:647799)
- Macrocephaly (HP:0000256): Occipitofrontal (head) circumference greater than 97th centile compared to appropriate, age matched, sex-matched normal standards. Alternatively, a apparently increased size of the cranium. Evidence: TAS. Frequency: Very rare (HP:0040284). (ORPHA:647799)
- Myopia (HP:0000545): An abnormality of refraction characterized by the ability to see objects nearby clearly, while objects in the distance appear blurry. Evidence: TAS. Frequency: Very rare (HP:0040284). (ORPHA:647799)
- Nystagmus (HP:0000639): Rhythmic, involuntary oscillations of one or both eyes related to abnormality in fixation, conjugate gaze, or vestibular mechanisms. Evidence: TAS. Frequency: Very rare (HP:0040284). (ORPHA:647799)
- Oculomotor apraxia (HP:0000657): Ocular motor apraxia is a deficiency in voluntary, horizontal, lateral, fast eye movements (saccades) with retention of slow pursuit movements. The inability to follow objects visually is often compensated by head movements. There may be decreased smooth pursuit, and cancelation of the vestibulo-ocular reflex. Evidence: TAS. Frequency: Very rare (HP:0040284). (ORPHA:647799)
- Congenital diaphragmatic hernia (HP:0000776): The presence of a hernia of the diaphragm present at birth. Evidence: TAS. Frequency: Very rare (HP:0040284). (ORPHA:647799)
- Hashimoto thyroiditis (HP:0000872): A chronic, autoimmune type of thyroiditis associated with hypothyroidism. Evidence: TAS. Frequency: Very rare (HP:0040284). (ORPHA:647799)
- Hyperlipidemia (HP:0003077): An elevated lipid concentration in the blood. Evidence: TAS. Frequency: Very rare (HP:0040284). (ORPHA:647799)
- Sleep apnea (HP:0010535): An intermittent cessation of airflow at the mouth and nose during sleep is known as sleep apnea. Apneas that last at least 10 seconds are considered significant, but individuals with sleep apnea may experience apneas lasting from 20 seconds up to 2 or 3 minutes. Patients may have up to 15 events per hour of sleep. Evidence: TAS. Frequency: Very rare (HP:0040284). (ORPHA:647799)
- Mild fetal ventriculomegaly (HP:0010952): A kind of ventriculomegaly occurring in the fetal period and usually diagnosed by prenatal ultrasound. Cerebral ventriculomegaly is defined by atrial measurements 10 mm or more. Mild ventriculomegaly (MVM) is defined as measurements between 10 and 15 mm. Measurements are obtained from an axial plane at the level of the thalamic nuclei just below the standard image to measure the BPD (PMID:16100637). Evidence: TAS. Frequency: Very rare (HP:0040284). (ORPHA:647799)
- Abnormal pituitary stalk morphology (HP:0034977): A structural anomaly of the pituitary stalk, also known as the infundibulum or infundibular stalk, is the connection between the hypothalamus and the pituitary gland. Evidence: TAS. Frequency: Very rare (HP:0040284). (ORPHA:647799)
These phenotypes are associated with the disease MYT1L-related developmental delay-intellectual disability-obesity syndrome (ORPHA:647799).